- Stroke (HP:0001297): Sudden impairment of blood flow to a part of the brain due to occlusion or rupture of an artery to the brain. Evidence: PCS. (PMID:23275345)
- Bradycardia (HP:0001662): A slower than normal heart rate (in adults, slower than 60 beats per minute). Evidence: TAS. (OMIM:615745)
- Atrial standstill (HP:0025478): Atrial standstill or silent atrium is a rare condition presenting with the absence of electrical and mechanical activity in the atria. It presents with the absence of P waves, bradycardia, and wide QRS complex in the electrocardiogram. Evidence: PCS. (PMID:23275345)
- Atrial arrhythmia (HP:0001692): A type of supraventricular tachycardia in which the atria are the principal site of electrophysiologic disturbance. Evidence: PCS. (PMID:23275345)
- Atrial cardiomyopathy (HP:0200127): Any complex of structural, architectural, contractile or electrophysiological changes affecting the atria with the potential to produce clinically relevant manifestations. Evidence: PCS. (PMID:23275345)
- Dyspnea (HP:0002094): Difficult or labored breathing. Dyspnea is a subjective feeling only the patient can rate, e.g., on a Borg scale. Evidence: PCS. (PMID:23275345)
- Scarring (HP:0100699): A scar refers to a lesion in which wound, burn, or sore has not healed completely and fibrous connective tissue has developed. Evidence: PCS. (PMID:23275345)
- Absent P wave (HP:0033122): The P wave that normally precedes each QRS complex by a fixed PR interval of 120 to 200 milliseconds is not present. Evidence: PCS. (PMID:23275345)
- Autosomal recessive inheritance (HP:0000007): A mode of inheritance that is observed for traits related to a gene encoded on one of the autosomes (i.e., the human chromosomes 1-22) in which a trait manifests in individuals with two pathogenic alleles, either homozygotes (two copies of the same mutant allele) or compound heterozygotes (whereby each copy of a gene has a distinct mutant allele). Evidence: PCS. (PMID:23275345)
- Vascular dilatation (HP:0002617): An abnormal increase in the diameter of an artery or vein, either as a diffuse dilatation or as a localized, sac-like outpouching of the vessel wall (aneurysm). Evidence: PCS. (PMID:23275345)
- Cardiomyopathy (HP:0001638): A myocardial disorder in which the heart muscle is structurally and functionally abnormal, in the absence of coronary artery disease, hypertension, valvular disease and congenital heart disease sufficient to cause the observed myocardial abnormality. Evidence: IEA. (OMIM:615745)
- Palpitations (HP:0001962): A sensation that the heart is pounding or racing, which is a non-specific sign but may be a manifestation of arrhythmia. Evidence: PCS. (PMID:23275345)
- Dilatation of the ventricular cavity (HP:0006698): A localized outpouching of ventricular cavity that is generally associated with dyskinesia and paradoxical expansion during systole. Evidence: PCS. (PMID:23275345)
- Hyperpepsinogenemia I (HP:0003238): The concentration of pepsinogen I in the blood circulation is above the upper limit of normal. Evidence: PCS. (PMID:23275345)
These phenotypes are associated with the disease atrial standstill 2 (OMIM:615745).